- Stomatocytosis (HP:0004446): The presence of erythrocytes with a mouth-shaped (stoma) area of central pallor on peripheral blood smear. Evidence: PCS. (PMID:9657769)
- Chronic hemolytic anemia (HP:0004870): An chronic form of hemolytic anemia. Evidence: PCS. (PMID:9657769)
- Autosomal recessive inheritance (HP:0000007): A mode of inheritance that is observed for traits related to a gene encoded on one of the autosomes (i.e., the human chromosomes 1-22) in which a trait manifests in individuals with two pathogenic alleles, either homozygotes (two copies of the same mutant allele) or compound heterozygotes (whereby each copy of a gene has a distinct mutant allele). Evidence: PCS. (PMID:9657769)
These phenotypes are associated with the disease RHESUS BLOOD GROUP, CcEe ANTIGENS; RHCE (OMIM:111700).